- Poor head control (HP:0002421): Difficulty to maintain correct position of the head while standing or sitting. Infant head lag is observed when the head seems to flop around or lags posteriorly behind the trunk. Several articles have maintained that head lag should be absent by age 3 to 4 months. Evidence: PCS. Frequency: 2/2. (PMID:30256902)
- Microcephaly (HP:0000252): Head circumference below 2 standard deviations below the mean for age and gender. Evidence: PCS. Frequency: 1/1. (PMID:23033978)
- Hypsarrhythmia (HP:0002521): Hypsarrhythmia is abnormal interictal high amplitude waves and a background of irregular spikes. There is continuous (during wakefulness), high-amplitude (>200 Hz), generalized polymorphic slowing with no organized background and multifocal spikes demonstrated by electroencephalography (EEG). Evidence: PCS. Frequency: 2/2. (PMID:30256902)
- Polyhydramnios (HP:0001561): The presence of excess amniotic fluid in the uterus during pregnancy. Evidence: PCS. Frequency: 1/2. Onset: Fetal onset (HP:0011461). (PMID:30256902)
- Scoliosis (HP:0002650): The presence of an abnormal lateral curvature of the spine. Evidence: PCS. Frequency: 1/1. (PMID:23033978)
- Delayed CNS myelination (HP:0002188): Delayed myelination in the central nervous system. Evidence: PCS. Frequency: 1/2. (PMID:30256902)
- Seizure (HP:0001250): A seizure is an intermittent abnormality of nervous system physiology characterized by a transient occurrence of signs and/or symptoms due to abnormal excessive or synchronous neuronal activity in the brain. Evidence: PCS. Frequency: 1/1. (PMID:23033978)
- Flexion contracture (HP:0001371): A flexion contracture is a bent (flexed) joint that cannot be straightened actively or passively. It is thus a chronic loss of joint motion due to structural changes in muscle, tendons, ligaments, or skin that prevents normal movement of joints. Evidence: PCS. Frequency: 1/1. (PMID:23033978)
- Cerebral cortical atrophy (HP:0002120): Atrophy of the cortex of the cerebrum. Evidence: PCS. Frequency: 1/2. (PMID:30256902)
- Narrow mouth (HP:0000160): Distance between the commissures of the mouth more than 2 SD below the mean. Alternatively, an apparently decreased width of the oral aperture (subjective). Evidence: PCS. Frequency: 1/2. (PMID:30256902)
- Spastic tetraparesis (HP:0001285): Spastic weakness affecting all four limbs. Evidence: PCS. Frequency: 1/1. (PMID:23033978)
- Hypotonia (HP:0001252): Hypotonia is an abnormally low muscle tone (the amount of tension or resistance to movement in a muscle). Even when relaxed, muscles have a continuous and passive partial contraction which provides some resistance to passive stretching. Hypotonia thus manifests as diminished resistance to passive stretching. Hypotonia is not the same as muscle weakness, although the two conditions can co-exist. Evidence: PCS. Frequency: 1/2. (PMID:30256902)
- Severe global developmental delay (HP:0011344): A severe delay in the achievement of motor or mental milestones in the domains of development of a child. Evidence: PCS. Frequency: 1/1. (PMID:23033978)
- Epileptic spasm (HP:0011097): A sudden flexion, extension, or mixed extension-flexion of predominantly proximal and truncal muscles that is usually more sustained than a myoclonic movement but not as sustained as a tonic seizure. Limited forms may occur: Grimacing, head nodding, or subtle eye movements. Epileptic spasms frequently occur in clusters. Infantile spasms are the best known form, but spasms can occur at all ages. Evidence: PCS. Frequency: 2/2. Onset: Infantile onset (HP:0003593). (PMID:30256902)
- Tonic seizure (HP:0032792): A tonic seizure is a type of motor seizure characterized by unilateral or bilateral limb stiffening or elevation, often with neck stiffening. Evidence: PCS. Frequency: 2/2. Onset: Infantile onset (HP:0003593). (PMID:30256902)
- Autistic behavior (HP:0000729): Persistent deficits in social interaction and communication and interaction as well as a markedly restricted repertoire of activity and interest as well as repetitive patterns of behavior. Evidence: PCS. Frequency: 1/2. (PMID:30256902)
- Hypertelorism (HP:0000316): Interpupillary distance more than 2 SD above the mean (alternatively, the appearance of an increased interpupillary distance or widely spaced eyes). Evidence: PCS. Frequency: 1/2. (PMID:30256902)
- Ventriculomegaly (HP:0002119): An increase in size of the ventricular system of the brain. Evidence: PCS. Frequency: 1/2. (PMID:30256902)
- Epileptic encephalopathy (HP:0200134): A condition in which epileptiform abnormalities are believed to contribute to the progressive disturbance in cerebral function. Epileptic encephalaopathy is characterized by (1) electrographic EEG paroxysmal activity that is often aggressive, (2) seizures that are usually multiform and intractable, (3) cognitive, behavioral and neurological deficits that may be relentless, and (4) sometimes early death. Evidence: PCS. (PMID:30256902)
- Low-set ears (HP:0000369): Upper insertion of the ear to the scalp below an imaginary horizontal line drawn between the inner canthi of the eye and extending posteriorly to the ear. Evidence: PCS. Frequency: 1/2. (PMID:30256902)
- Cryptorchidism (HP:0000028): Testis in inguinal canal. That is, absence of one or both testes from the scrotum owing to failure of the testis or testes to descend through the inguinal canal to the scrotum. Evidence: PCS. Frequency: 1/2. (PMID:30256902)
- Autosomal dominant inheritance (HP:0000006): A mode of inheritance that is observed for traits related to a gene encoded on one of the autosomes (i.e., the human chromosomes 1-22) in which a trait manifests in heterozygotes. In the context of medical genetics, an autosomal dominant disorder is caused when a single copy of the mutant allele is present. Males and females are affected equally, and can both transmit the disorder with a risk of 50% for each child of inheriting the mutant allele. Evidence: PCS. (PMID:30256902)
- Intellectual disability (HP:0001249): The term intellectual disability or intellectual developmental disorder is used to describe significantly sub-average intellectual and adaptive functioning based on clinical assessment and as measured by individually administered, appropriately normed, standardized and validated tests of intellectual functioning and adaptive behavior, with onset during the developmental period from infancy through adolescence. Evidence: PCS. Frequency: 2/2. (PMID:30256902)
These phenotypes are associated with the disease developmental and epileptic encephalopathy, 70 (OMIM:618298).